Phenotypes associated with the disease Eosinophilic fasciitis (ORPHA:3165):
- Edema (HP:0000969): An abnormal accumulation of fluid beneath the skin, or in one or more cavities of the body. Evidence: TAS. Frequency: Very frequent (HP:0040281). (ORPHA:3165)
- Acrocyanosis (HP:0001063): Bluish discoloration of the skin of the hands or feet. Evidence: TAS. Frequency: Very frequent (HP:0040281). (ORPHA:3165)
- Arthritis (HP:0001369): Inflammation of a joint. Evidence: TAS. Frequency: Frequent (HP:0040282). (ORPHA:3165)
- Subcutaneous nodule (HP:0001482): Slightly elevated lesions on or in the skin with a diameter of over 5 mm. Evidence: TAS. Frequency: Very frequent (HP:0040281). (ORPHA:3165)
- Weight loss (HP:0001824): Reduction of total body weight. Evidence: TAS. Frequency: Occasional (HP:0040283). (ORPHA:3165)
- Abnormal eosinophil morphology (HP:0001879): An abnormal count or structure of eosinophils. Evidence: TAS. Frequency: Very frequent (HP:0040281). (ORPHA:3165)
- Increased total eosinophil count (HP:0001880): Increased count of eosinophils in the blood. Evidence: TAS. Frequency: Very frequent (HP:0040281). (ORPHA:3165)
- Arthralgia (HP:0002829): Joint pain. Evidence: TAS. Frequency: Frequent (HP:0040282). (ORPHA:3165)
- Myalgia (HP:0003326): Pain in muscle. Evidence: TAS. Frequency: Very frequent (HP:0040281). (ORPHA:3165)
- Paresthesia (HP:0003401): Abnormal sensations such as tingling, pricking, or numbness of the skin with no apparent physical cause. Evidence: TAS. Frequency: Occasional (HP:0040283). (ORPHA:3165)
- Fatigue (HP:0012378): A subjective feeling of tiredness characterized by a lack of energy and motivation. Evidence: TAS. Frequency: Very frequent (HP:0040281). (ORPHA:3165)
- Macule (HP:0012733): A flat, distinct, discolored area of skin less than 1 cm wide that does not involve any change in the thickness or texture of the skin. Evidence: TAS. Frequency: Very frequent (HP:0040281). (ORPHA:3165)
- Fasciitis (HP:0100537): Inflammation of fascia, the tissue under the skin and over the muscle. Evidence: TAS. Frequency: Occasional (HP:0040283). (ORPHA:3165)
- Myositis (HP:0100614): A general term for inflammation of the muscles without respect to the underlying cause. Evidence: TAS. Frequency: Occasional (HP:0040283). (ORPHA:3165)
- Cellulitis (HP:0100658): A bacterial infection and inflammation of the skin und subcutaneous tissues. Evidence: TAS. Frequency: Very frequent (HP:0040281). (ORPHA:3165)
- Muscular edema (HP:0100748). Evidence: TAS. Frequency: Very frequent (HP:0040281). (ORPHA:3165)